- Acute monocytic leukemia (HP:0004845): The accumulation of transformed primitive hematopoietic blast cells, which lose their ability of normal differentiation and proliferation. Evidence: TAS. Frequency: Obligate (HP:0040280). (ORPHA:514)
- Anemia (HP:0001903): A reduction in erythrocytes volume or hemoglobin concentration. Evidence: TAS. Frequency: Frequent (HP:0040282). (ORPHA:514)
- Increased total leukocyte count (HP:0001974): An abnormal increase in the number of leukocytes in the blood. Evidence: TAS. Frequency: Frequent (HP:0040282). (ORPHA:514)
- Exertional dyspnea (HP:0002875): Perceived difficulty to breathe that occurs with exercise or exertion and improves with rest. Evidence: TAS. Frequency: Frequent (HP:0040282). (ORPHA:514)
- Fatigue (HP:0012378): A subjective feeling of tiredness characterized by a lack of energy and motivation. Evidence: TAS. Frequency: Frequent (HP:0040282). (ORPHA:514)
- Bone marrow hypercellularity (HP:0031020): A larger than normal amount or percentage of hematopoietic cells relative to marrow fat. Evidence: TAS. Frequency: Frequent (HP:0040282). (ORPHA:514)
- Increased total lymphocyte count (HP:0100827): Increase in the number or proportion of lymphocytes in the blood. Evidence: TAS. Frequency: Frequent (HP:0040282). (ORPHA:514)
- Subcutaneous nodule (HP:0001482): Slightly elevated lesions on or in the skin with a diameter of over 5 mm. Evidence: TAS. Frequency: Occasional (HP:0040283). (ORPHA:514)
- Progressive hearing impairment (HP:0001730): A progressive form of hearing impairment. Evidence: TAS. Frequency: Occasional (HP:0040283). (ORPHA:514)
- Ankle swelling (HP:0001785). Evidence: TAS. Frequency: Occasional (HP:0040283). (ORPHA:514)
- Weight loss (HP:0001824): Reduction of total body weight. Evidence: TAS. Frequency: Occasional (HP:0040283). (ORPHA:514)
- Hypochromic anemia (HP:0001931): A type of anemia characterized by an abnormally low concentration of hemoglobin in the erythrocytes. Evidence: TAS. Frequency: Occasional (HP:0040283). (ORPHA:514)
- Fever (HP:0001945): Body temperature elevated above the normal range. Evidence: TAS. Frequency: Occasional (HP:0040283). (ORPHA:514)
- Anorexia (HP:0002039): Lack of desire to eat (loss of appetite). Evidence: TAS. Frequency: Occasional (HP:0040283). (ORPHA:514)
- Central hypothyroidism (HP:0011787): A type of hypothyroidism due to an insufficient stimulation of an otherwise normal thyroid gland. Central hypothyroidism is caused by either pituitary (secondary hypothyroidism) or hypothalamic (tertiary hypothyroidism) defects. Evidence: TAS. Frequency: Occasional (HP:0040283). (ORPHA:514)
- Abnormality of multiple cell lineages in the bone marrow (HP:0012145). Evidence: TAS. Frequency: Occasional (HP:0040283). (ORPHA:514)
- Cervical lymphadenopathy (HP:0025289): Enlarged lymph nodes in the neck. Evidence: TAS. Frequency: Occasional (HP:0040283). (ORPHA:514)
- Increased circulating lactate dehydrogenase concentration (HP:0025435): An elevated level of the enzyme lactate dehydrogenase in the blood circulation. Evidence: TAS. Frequency: Occasional (HP:0040283). (ORPHA:514)
- Oliguria (HP:0100520): Low output of urine, clinically classified as an output below 300-500ml/day. Evidence: TAS. Frequency: Occasional (HP:0040283). (ORPHA:514)
- Periorbital edema (HP:0100539): Edema affecting the region situated around the orbit of the eye. Evidence: TAS. Frequency: Occasional (HP:0040283). (ORPHA:514)
These phenotypes are associated with the disease Acute monoblastic/monocytic leukemia (ORPHA:514).